- Juvenile onset (HP:0003621, a Human Phenotype Ontology term): Onset of signs or symptoms of disease between the age of 5 and 15 years. Evidence: PCS. Frequency: 1/6. (PMID:20970104)
- Hypertrophic cardiomyopathy (HP:0001639, a Human Phenotype Ontology term): Hypertrophic cardiomyopathy (HCM) is defined by the presence of increased ventricular wall thickness or mass in the absence of loading conditions (hypertension, valve disease) sufficient to cause the observed abnormality. Evidence: PCS. Frequency: 6/6. (PMID:20970104)
- Adult onset (HP:0003581, a Human Phenotype Ontology term): Onset of disease manifestations in adulthood, defined here as at the age of 16 years or later. Evidence: PCS. Frequency: 5/6. (PMID:20970104)
- Atrial fibrillation (HP:0005110, a Human Phenotype Ontology term): An atrial arrhythmia characterized by disorganized atrial activity without discrete P waves on the surface EKG, but instead by an undulating baseline or more sharply circumscribed atrial deflections of varying amplitude an frequency ranging from 350 to 600 per minute. Evidence: PCS. Frequency: 1/6. (PMID:20970104)
- Left ventricular hypertrophy (HP:0001712, a Human Phenotype Ontology term): Enlargement or increased size of the heart left ventricle. Evidence: PCS. Frequency: 6/6. (PMID:20970104)
- Reduced left ventricular ejection fraction (HP:0012664, a Human Phenotype Ontology term): A diminution of the volumetric fraction of blood pumped out of the ventricle with each cardiac cycle. Evidence: PCS. Frequency: 0/6. (PMID:20970104)
- Autosomal dominant inheritance (HP:0000006, a Human Phenotype Ontology term): A mode of inheritance that is observed for traits related to a gene encoded on one of the autosomes (i.e., the human chromosomes 1-22) in which a trait manifests in heterozygotes. In the context of medical genetics, an autosomal dominant disorder is caused when a single copy of the mutant allele is present. Males and females are affected equally, and can both transmit the disorder with a risk of 50% for each child of inheriting the mutant allele. Evidence: PCS. (PMID:20970104)
These phenotypes are associated with the disease hypertrophic cardiomyopathy 20 (OMIM:613876, an entry in Online Mendelian Inheritance in Man).